Phenotypes associated with the disease Autosomal dominant spondylocostal dysostosis (ORPHA:1797):
- Intrauterine growth retardation (HP:0001511): An abnormal restriction of fetal growth with fetal weight below the tenth percentile for gestational age. Evidence: TAS. Frequency: Very frequent (HP:0040281). (ORPHA:1797)
- Scoliosis (HP:0002650): The presence of an abnormal lateral curvature of the spine. Evidence: TAS. Frequency: Very frequent (HP:0040281). (ORPHA:1797)
- Vertebral segmentation defect (HP:0003422): An abnormality related to a defect of vertebral separation during development. Evidence: TAS. Frequency: Very frequent (HP:0040281). (ORPHA:1797)
- Severe short stature (HP:0003510): A severe degree of short stature, more than -4 SD from the mean corrected for age and sex. Evidence: TAS. Frequency: Very frequent (HP:0040281). (ORPHA:1797)
- Prominent occiput (HP:0000269): Increased convexity of the occiput (posterior part of the skull). Evidence: TAS. Frequency: Frequent (HP:0040282). (ORPHA:1797)
- Wide nasal bridge (HP:0000431): Increased breadth of the nasal bridge (and with it, the nasal root). Evidence: TAS. Frequency: Frequent (HP:0040282). (ORPHA:1797)
- Anteverted nares (HP:0000463): Anteriorly-facing nostrils viewed with the head in the Frankfurt horizontal and the eyes of the observer level with the eyes of the subject. This gives the appearance of an upturned nose (upturned nasal tip). Evidence: TAS. Frequency: Frequent (HP:0040282). (ORPHA:1797)
- Short neck (HP:0000470): Diminished length of the neck. Evidence: TAS. Frequency: Frequent (HP:0040282). (ORPHA:1797)
- Upslanted palpebral fissure (HP:0000582): The palpebral fissure inclination is more than two standard deviations above the mean for age (objective); or, the inclination of the palpebral fissure is greater than typical for age. Evidence: TAS. Frequency: Frequent (HP:0040282). (ORPHA:1797)
- Hyperlordosis (HP:0003307): Abnormally increased curvature (anterior concavity) of the lumbar or cervical spine. Evidence: TAS. Frequency: Frequent (HP:0040282). (ORPHA:1797)
- Short thorax (HP:0010306): Reduced inferior to superior extent of the thorax. Evidence: TAS. Frequency: Frequent (HP:0040282). (ORPHA:1797)
- Abnormal morphology of female internal genitalia (HP:0000008): An abnormality of the female internal genitalia. Evidence: TAS. Frequency: Occasional (HP:0040283). (ORPHA:1797)
- Cleft palate (HP:0000175): Cleft palate is a developmental defect of the palate resulting from a failure of fusion of the palatine processes and manifesting as a separation of the roof of the mouth (soft and hard palate). Evidence: TAS. Frequency: Occasional (HP:0040283). (ORPHA:1797)
- Microcephaly (HP:0000252): Head circumference below 2 standard deviations below the mean for age and gender. Evidence: TAS. Frequency: Occasional (HP:0040283). (ORPHA:1797)
- Macrocephaly (HP:0000256): Occipitofrontal (head) circumference greater than 97th centile compared to appropriate, age matched, sex-matched normal standards. Alternatively, a apparently increased size of the cranium. Evidence: TAS. Frequency: Occasional (HP:0040283). (ORPHA:1797)
- Abnormal rib morphology (HP:0000772): An anomaly of the rib. Evidence: TAS. Frequency: Occasional (HP:0040283). (ORPHA:1797)
- Posterior rib fusion (HP:0000913): Complete or partial merging of the posterior part of adjacent ribs. Evidence: TAS. Frequency: Occasional (HP:0040283). (ORPHA:1797)
- Missing ribs (HP:0000921): A developmental anomaly with absence of one or more ribs. Evidence: TAS. Frequency: Occasional (HP:0040283). (ORPHA:1797)
- Recurrent respiratory infections (HP:0002205): An increased susceptibility to respiratory infections as manifested by a history of recurrent respiratory infections. Evidence: TAS. Frequency: Occasional (HP:0040283). (ORPHA:1797)
- Spina bifida occulta (HP:0003298): The closed form of spina bifida with incomplete closure of a vertebral body with intact overlying skin. Evidence: TAS. Frequency: Occasional (HP:0040283). (ORPHA:1797)
- Abnormal sacrum morphology (HP:0005107): An abnormality of the sacral bone. Evidence: TAS. Frequency: Occasional (HP:0040283). (ORPHA:1797)
- Abnormal cardiovascular system morphology (HP:0030680): Any structural anomaly of the heart and blood vessels. Evidence: TAS. Frequency: Occasional (HP:0040283). (ORPHA:1797)